Phenotypes associated with the disease Marshall-Smith syndrome (ORPHA:561):
- Joint hypermobility (HP:0001382): The capability that a joint (or a group of joints) has to move, passively and/or actively, beyond normal limits along physiological axes. Evidence: TAS. Frequency: Very frequent (HP:0040281). (ORPHA:561)
- Retrognathia (HP:0000278): An abnormality in which the mandible is mislocalised posteriorly. Evidence: TAS. Frequency: Very frequent (HP:0040281). (ORPHA:561)
- Anteverted nares (HP:0000463): Anteriorly-facing nostrils viewed with the head in the Frankfurt horizontal and the eyes of the observer level with the eyes of the subject. This gives the appearance of an upturned nose (upturned nasal tip). Evidence: TAS. Frequency: Very frequent (HP:0040281). (ORPHA:561)
- Proptosis (HP:0000520): An eye that is protruding anterior to the plane of the face to a greater extent than is typical. Evidence: TAS. Frequency: Very frequent (HP:0040281). (ORPHA:561)
- Thin skin (HP:0000963): Reduction in thickness of the skin, generally associated with a loss of suppleness and elasticity of the skin. Evidence: TAS. Frequency: Very frequent (HP:0040281). (ORPHA:561)
- Intellectual disability (HP:0001249): The term intellectual disability or intellectual developmental disorder is used to describe significantly sub-average intellectual and adaptive functioning based on clinical assessment and as measured by individually administered, appropriately normed, standardized and validated tests of intellectual functioning and adaptive behavior, with onset during the developmental period from infancy through adolescence. Evidence: TAS. Frequency: Very frequent (HP:0040281). (ORPHA:561)
- Failure to thrive (HP:0001508): Failure to thrive (FTT) refers to a child whose physical growth is substantially below the norm. Evidence: TAS. Frequency: Very frequent (HP:0040281). (ORPHA:561)
- Slender long bone (HP:0003100): Reduced diameter of a long bone. Evidence: TAS. Frequency: Very frequent (HP:0040281). (ORPHA:561)
- Accelerated skeletal maturation (HP:0005616): An abnormally increased rate of skeletal maturation. Accelerated skeletal maturation can be diagnosed on the basis of an estimation of the bone age from radiographs of specific bones in the human body. Evidence: TAS. Frequency: Very frequent (HP:0040281). (ORPHA:561)
- Bowing of the long bones (HP:0006487): A bending or abnormal curvature of a long bone. Evidence: TAS. Frequency: Very frequent (HP:0040281). (ORPHA:561)
- Prominent forehead (HP:0011220): Forward prominence of the entire forehead, due to protrusion of the frontal bone. Evidence: TAS. Frequency: Very frequent (HP:0040281). (ORPHA:561)
- Open mouth (HP:0000194): A facial appearance characterized by a permanently or nearly permanently opened mouth. Evidence: TAS. Frequency: Frequent (HP:0040282). (ORPHA:561)
- Hypertelorism (HP:0000316): Interpupillary distance more than 2 SD above the mean (alternatively, the appearance of an increased interpupillary distance or widely spaced eyes). Evidence: TAS. Frequency: Frequent (HP:0040282). (ORPHA:561)
- Conductive hearing impairment (HP:0000405): An abnormality of vibrational conductance of sound to the inner ear leading to impairment of sensory perception of sound. Evidence: TAS. Frequency: Frequent (HP:0040282). (ORPHA:561)
- Blue sclerae (HP:0000592): An abnormal bluish coloration of the sclera. Evidence: TAS. Frequency: Frequent (HP:0040282). (ORPHA:561)
- Bruising susceptibility (HP:0000978): An ecchymosis (bruise) refers to the skin discoloration caused by the escape of blood into the tissues from ruptured blood vessels. This term refers to an abnormally increased susceptibility to bruising. The corresponding phenotypic abnormality is generally elicited on medical history as a report of frequent ecchymoses or bruising without adequate trauma. Evidence: TAS. Frequency: Frequent (HP:0040282). (ORPHA:561)
- Generalized hirsutism (HP:0002230): Abnormally increased hair growth over much of the entire body. Evidence: TAS. Frequency: Frequent (HP:0040282). (ORPHA:561)
- Scoliosis (HP:0002650): The presence of an abnormal lateral curvature of the spine. Evidence: TAS. Frequency: Frequent (HP:0040282). (ORPHA:561)
- Increased susceptibility to fractures (HP:0002659): An abnormally increased tendency to fractures of bones caused by an abnormal reduction in bone strength that is generally associated with an increased risk of fracture. Evidence: TAS. Frequency: Frequent (HP:0040282). (ORPHA:561)
- Short nose (HP:0003196): Distance from nasion to subnasale more than two standard deviations below the mean, or alternatively, an apparently decreased length from the nasal root to the nasal tip. Evidence: TAS. Frequency: Frequent (HP:0040282). (ORPHA:561)
- Reduced bone mineral density (HP:0004349): A reduction of bone mineral density, that is, of the amount of matter per cubic centimeter of bones. Evidence: TAS. Frequency: Frequent (HP:0040282). (ORPHA:561)
- Protruding tongue (HP:0010808): Tongue extending beyond the alveolar ridges or teeth at rest. Evidence: TAS. Frequency: Frequent (HP:0040282). (ORPHA:561)
- Gingival overgrowth (HP:0000212): Hyperplasia of the gingiva (that is, a thickening of the soft tissue overlying the alveolar ridge. The degree of thickening ranges from involvement of the interdental papillae alone to gingival overgrowth covering the entire tooth crown. Evidence: TAS. Frequency: Occasional (HP:0040283). (ORPHA:561)
- Choanal atresia (HP:0000453): Absence or abnormal closure of the choana (the posterior nasal aperture). Most embryologists believe that posterior choanal atresia results from a failure of rupture between the 35th and 38th day of fetal life of the partition which separates the bucconasal or buccopharyngeal membranes. The resultant choanal atresia may be unilateral or bilateral, bony or membranous, complete or incomplete. In over 90 per cent of cases the obstruction is bony, while in the remainder it is membranous. The bony type of atresia is commonly located 1-2 mm. anterior to the posterior edge of the hard palate, and the osseous septum varies in thickness from 1 to 10 mm. In the membranous form of choanal atresia the obstruction usually occurs further posteriorly. In approximately one third of cases the atresia is bilateral. Evidence: TAS. Frequency: Occasional (HP:0040283). (ORPHA:561)
- Optic atrophy (HP:0000648): Atrophy of the optic nerve. Optic atrophy results from the death of the retinal ganglion cell axons that comprise the optic nerve and manifesting as a pale optic nerve on fundoscopy. Evidence: TAS. Frequency: Occasional (HP:0040283). (ORPHA:561)
- Cerebellar hypoplasia (HP:0001321): Cerebellar hypoplasia is a descriptive term implying a cerebellum with a reduced volume, but a normal shape and is stable over time. Evidence: TAS. Frequency: Occasional (HP:0040283). (ORPHA:561)
- Craniosynostosis (HP:0001363): Craniosynostosis refers to the premature closure of the cranial sutures. Primary craniosynostosis refers to the closure of one or more sutures due to abnormalities in skull development, and secondary craniosynostosis results from failure of brain growth. Evidence: TAS. Frequency: Occasional (HP:0040283). (ORPHA:561)
- Ventriculomegaly (HP:0002119): An increase in size of the ventricular system of the brain. Evidence: TAS. Frequency: Occasional (HP:0040283). (ORPHA:561)
- Abnormal cardiovascular system morphology (HP:0030680): Any structural anomaly of the heart and blood vessels. Evidence: TAS. Frequency: Occasional (HP:0040283). (ORPHA:561)